Phenotypes associated with the disease asthma, nasal polyps, and aspirin intolerance (OMIM:208550):
- Asthma (HP:0002099): Asthma is characterized by increased responsiveness of the tracheobronchial tree to multiple stimuli, leading to narrowing of the air passages with resultant dyspnea, cough, and wheezing. Evidence: IEA. (OMIM:208550)
- Aspirin-induced asthma (HP:0012042): A type of asthma in which aspirin and other nonsteroidal anti-inflammatory drugs (NSAIDs) that inhibit cyclooxygen-ase 1 (COX-1) exacerbate bronchoconstriction. Evidence: TAS. (OMIM:208550)
- Autosomal recessive inheritance (HP:0000007): A mode of inheritance that is observed for traits related to a gene encoded on one of the autosomes (i.e., the human chromosomes 1-22) in which a trait manifests in individuals with two pathogenic alleles, either homozygotes (two copies of the same mutant allele) or compound heterozygotes (whereby each copy of a gene has a distinct mutant allele). Evidence: IEA. (OMIM:208550)
- Nasal polyposis (HP:0100582): Polypoidal masses arising mainly from the mucous membranes of the nose and paranasal sinuses. They are freely movable and nontender overgrowths of the mucosa that frequently accompany allergic rhinitis. Evidence: TAS. (OMIM:208550)
- Bronchoconstriction (HP:4000007): Tightening of smooth muscle surrounding the bronchi and bronchioles with consequent wheezing and shortness of breath. Evidence: TAS. (OMIM:208550)